Phenotypes associated with the disease Spastic ataxia with congenital miosis (ORPHA:1182):
- Nystagmus (HP:0000639): Rhythmic, involuntary oscillations of one or both eyes related to abnormality in fixation, conjugate gaze, or vestibular mechanisms. Evidence: TAS. Frequency: Frequent (HP:0040282). (ORPHA:1182)
- Seizure (HP:0001250): A seizure is an intermittent abnormality of nervous system physiology characterized by a transient occurrence of signs and/or symptoms due to abnormal excessive or synchronous neuronal activity in the brain. Evidence: TAS. Frequency: Occasional (HP:0040283). (ORPHA:1182)
- Ataxia (HP:0001251): Ataxia refers to impaired coordination of voluntary muscle movement. Cerebellar ataxia refers to ataxia due to dysfunction of the cerebellum. This causes a variety of elementary neurological deficits including asynergy (lack of coordination between muscles, limbs and joints), dysmetria (lack of ability to judge distances that can lead to under- or overshoot in grasping movements), and dysdiadochokinesia (inability to perform rapid movements requiring antagonizing muscle groups to be switched on and off repeatedly). Evidence: TAS. Frequency: Very frequent (HP:0040281). (ORPHA:1182)
- Dysarthria (HP:0001260): Dysarthric speech is a general description referring to a neurological speech disorder characterized by poor articulation. Depending on the involved neurological structures, dysarthria may be further classified as spastic, flaccid, ataxic, hyperkinetic and hypokinetic, or mixed. Evidence: TAS. Frequency: Very frequent (HP:0040281). (ORPHA:1182)
- Hyperreflexia (HP:0001347): Hyperreflexia is the presence of hyperactive stretch reflexes of the muscles. Evidence: TAS. Frequency: Frequent (HP:0040282). (ORPHA:1182)
- Spastic ataxia (HP:0002497). Evidence: TAS. Frequency: Frequent (HP:0040282). (ORPHA:1182)
- Hemiplegia/hemiparesis (HP:0004374): Loss of strength in the arm, leg, and sometimes face on one side of the body. Hemiplegia refers to a severe or complete loss of strength, whereas hemiparesis refers to a relatively mild loss of strength. Evidence: TAS. Frequency: Frequent (HP:0040282). (ORPHA:1182)
- Congenital miosis (HP:0007728): Abnormal (non-physiological) constriction of the pupil of congenital onset. Evidence: TAS. Frequency: Very frequent (HP:0040281). (ORPHA:1182)